- Encephalopathy (HP:0001298): Encephalopathy is a term that means brain disease, damage, or malfunction. In general, encephalopathy is manifested by an altered mental state. Evidence: PCS. Frequency: 1/1. (PMID:22499348)
- Myopathy (HP:0003198): A disorder of muscle unrelated to impairment of innervation or neuromuscular junction. Evidence: PCS. Frequency: 1/1. (PMID:22499348)
- Feeding difficulties (HP:0011968): Impaired ability to eat related to problems gathering food and getting ready to suck, chew, or swallow it. Evidence: PCS. Frequency: 1/1. (PMID:22277967)
- Antenatal onset (HP:0030674): Onset prior to birth. Evidence: PCS. Frequency: 1/1. (PMID:22277967)
- Hypotonia (HP:0001252): Hypotonia is an abnormally low muscle tone (the amount of tension or resistance to movement in a muscle). Even when relaxed, muscles have a continuous and passive partial contraction which provides some resistance to passive stretching. Hypotonia thus manifests as diminished resistance to passive stretching. Hypotonia is not the same as muscle weakness, although the two conditions can co-exist. Evidence: PCS. Frequency: 1/1. (PMID:22499348)
- Global developmental delay (HP:0001263): A delay in the achievement of motor or mental milestones in the domains of development of a child, including motor skills, speech and language, cognitive skills, and social and emotional skills. This term should only be used to describe children younger than five years of age. Evidence: PCS. Frequency: 1/1. (PMID:22499348)
- Decreased activity of mitochondrial complex I (HP:0011923): A reduction in the activity of the mitochondrial respiratory chain complex I, which is part of the electron transport chain in mitochondria. Evidence: PCS. Frequency: 2/2. (PMID:22499348;PMID:22277967)
- Failure to thrive (HP:0001508): Failure to thrive (FTT) refers to a child whose physical growth is substantially below the norm. Evidence: PCS. Frequency: 1/1. (PMID:22277967)
- Autosomal recessive inheritance (HP:0000007): A mode of inheritance that is observed for traits related to a gene encoded on one of the autosomes (i.e., the human chromosomes 1-22) in which a trait manifests in individuals with two pathogenic alleles, either homozygotes (two copies of the same mutant allele) or compound heterozygotes (whereby each copy of a gene has a distinct mutant allele). Evidence: PCS. (PMID:22277967)
- Intrauterine growth retardation (HP:0001511): An abnormal restriction of fetal growth with fetal weight below the tenth percentile for gestational age. Evidence: PCS. Frequency: 1/1. (PMID:22277967)
- Nemaline bodies (HP:0003798): Nemaline rods are abnormal bodies that can occur in skeletal muscle fibers. The rods can be observed on histological analysis of muscle biopsy tissue or upon electron microscopy, where they appear either as extensions of sarcomeric Z-lines, in random array without obvious attachment to Z-lines (often in areas devoid of sarcomeres) or in large clusters localized at the sarcolemma or intermyofibrillar spaces. Evidence: PCS. Frequency: 1/1. (PMID:22277967)
- Premature birth (HP:0001622): The birth of a baby of less than 37 weeks of gestational age. Evidence: PCS. Frequency: 1/1. (PMID:22277967)
- Lactic acidosis (HP:0003128): An abnormal buildup of lactic acid in the body, leading to acidification of the blood and other bodily fluids. Evidence: PCS. Frequency: 2/2. (PMID:22499348;PMID:22277967)
These phenotypes are associated with the disease mitochondrial complex I deficiency, nuclear type 25 (OMIM:618246).